Phenotypes associated with the disease mitochondrial complex I deficiency, nuclear type 12 (OMIM:301020):
- Bilateral tonic-clonic seizure (HP:0002069): A bilateral tonic-clonic seizure is a seizure defined by a tonic (bilateral increased tone, lasting seconds to minutes) and then a clonic (bilateral sustained rhythmic jerking) phase. Evidence: PCS. Frequency: 1/3. (PMID:19185523)
- Generalized myoclonic seizure (HP:0002123): A generalized myoclonic seizure is a type of generalized motor seizure characterized by bilateral, sudden, brief (<100 ms) involuntary single or multiple contraction of muscles or muscle groups of variable topography (axial, proximal limb, distal). Myoclonus is less regularly repetitive and less sustained than is clonus. Evidence: PCS. Frequency: 1/2. (PMID:17262856)
- Cerebellar atrophy (HP:0001272): Cerebellar atrophy is defined as a cerebellum with initially normal structures, in a posterior fossa with normal size, which displays enlarged fissures (interfolial spaces) in comparison to the foliae secondary to loss of tissue. Cerebellar atrophy implies irreversible loss of tissue and result from an ongoing progressive disease until a final stage is reached or a single injury, e.g. an intoxication or infectious event. Evidence: PCS. Frequency: 1/3. (PMID:19185523)
- Seizure (HP:0001250): A seizure is an intermittent abnormality of nervous system physiology characterized by a transient occurrence of signs and/or symptoms due to abnormal excessive or synchronous neuronal activity in the brain. Evidence: PCS. Frequency: 1/3. (PMID:19185523)
- Hypotonia (HP:0001252): Hypotonia is an abnormally low muscle tone (the amount of tension or resistance to movement in a muscle). Even when relaxed, muscles have a continuous and passive partial contraction which provides some resistance to passive stretching. Hypotonia thus manifests as diminished resistance to passive stretching. Hypotonia is not the same as muscle weakness, although the two conditions can co-exist. Evidence: PCS. Frequency: 1/3. (PMID:19185523)
- Ataxia (HP:0001251): Ataxia refers to impaired coordination of voluntary muscle movement. Cerebellar ataxia refers to ataxia due to dysfunction of the cerebellum. This causes a variety of elementary neurological deficits including asynergy (lack of coordination between muscles, limbs and joints), dysmetria (lack of ability to judge distances that can lead to under- or overshoot in grasping movements), and dysdiadochokinesia (inability to perform rapid movements requiring antagonizing muscle groups to be switched on and off repeatedly). Evidence: PCS. Frequency: 3/3. (PMID:19185523)
- Gait imbalance (HP:0002141). Evidence: PCS. Frequency: 1/3. (PMID:19185523)
- Infantile onset (HP:0003593): Onset of signs or symptoms of disease between 28 days to one year of life. Evidence: PCS. Frequency: 2/2. (PMID:17262856)
- Generalized hypotonia (HP:0001290): Generalized muscular hypotonia (abnormally low muscle tone). Evidence: PCS. Frequency: 1/2. (PMID:17262856)
- Aphasia (HP:0002381): An acquired language impairment of some or all of the abilities to produce or comprehend speech and to read or write. Evidence: PCS. Frequency: 1/3. (PMID:19185523)
- Nystagmus (HP:0000639): Rhythmic, involuntary oscillations of one or both eyes related to abnormality in fixation, conjugate gaze, or vestibular mechanisms. Evidence: PCS. Frequency: 1/2. (PMID:17262856)
- Childhood onset (HP:0011463): Onset of disease at the age of between 1 and 5 years. Evidence: PCS. Frequency: 3/3. (PMID:19185523)
- Unsteady gait (HP:0002317). Evidence: PCS. Frequency: 1/3. (PMID:19185523)
- Frequent falls (HP:0002359). Evidence: PCS. Frequency: 1/3. (PMID:19185523)
- Proximal muscle weakness (HP:0003701): A lack of strength of the proximal muscles. Evidence: PCS. Frequency: 1/3. (PMID:19185523)
- Rod-cone dystrophy (HP:0000510): An inherited retinal disease subtype in which the rod photoreceptors appear to be more severely affected than the cone photoreceptors. Typical presentation is with nyctalopia (due to rod dysfunction) followed by loss of mid-peripheral field of vision, which gradually extends and leaves many patients with a small central island of vision due to the preservation of macular cones. Evidence: PCS. Frequency: 1/3. (PMID:19185523)
- Intellectual disability (HP:0001249): The term intellectual disability or intellectual developmental disorder is used to describe significantly sub-average intellectual and adaptive functioning based on clinical assessment and as measured by individually administered, appropriately normed, standardized and validated tests of intellectual functioning and adaptive behavior, with onset during the developmental period from infancy through adolescence. Evidence: PCS. Frequency: 1/3. (PMID:19185523)
- Axial hypotonia (HP:0008936): Muscular hypotonia (abnormally low muscle tone) affecting the musculature of the trunk. Evidence: PCS. Frequency: 1/2. (PMID:17262856)
- Hyporeflexia (HP:0001265): Reduction of neurologic reflexes such as the knee-jerk reaction. Evidence: PCS. Frequency: 1/2. (PMID:17262856)
- Delayed speech and language development (HP:0000750): A degree of language development that is significantly below the norm for a child of a specified age. Evidence: PCS. Frequency: 1/2. (PMID:17262856)
- Choreoathetosis (HP:0001266): Involuntary movements characterized by both athetosis (inability to sustain muscles in a fixed position) and chorea (widespread jerky arrhythmic movements). Evidence: PCS. Frequency: 1/2. (PMID:17262856)
- Delayed ability to walk (HP:0031936): A failure to achieve the ability to walk at an appropriate developmental stage. Most children learn to walk in a series of stages, and learn to walk short distances independently between 12 and 15 months. Evidence: PCS. Frequency: 1/3. (PMID:19185523)
- Global developmental delay (HP:0001263): A delay in the achievement of motor or mental milestones in the domains of development of a child, including motor skills, speech and language, cognitive skills, and social and emotional skills. This term should only be used to describe children younger than five years of age. Evidence: PCS. Frequency: 2/2. (PMID:17262856)
- Increased circulating lactate concentration (HP:0002151): Abnormally increased level of blood lactate (2-hydroxypropanoic acid). Lactate is produced from pyruvate by lactate dehydrogenase during normal metabolism. The terms lactate and lactic acid are often used interchangeably but lactate (the component measured in blood) is strictly a weak base whereas lactic acid is the corresponding acid. Lactic acidosis is often used clinically to describe elevated lactate but should be reserved for cases where there is a corresponding acidosis (pH below 7.35). Evidence: PCS. Frequency: 1/3. (PMID:19185523)
- Decreased activity of mitochondrial complex I (HP:0011923): A reduction in the activity of the mitochondrial respiratory chain complex I, which is part of the electron transport chain in mitochondria. Evidence: PCS. Frequency: 3/3. (PMID:19185523;PMID:17262856)
- Progressive sensorineural hearing impairment (HP:0000408): A progressive form of sensorineural hearing impairment. Evidence: PCS. Frequency: 1/3. (PMID:19185523)
- Dementia (HP:0000726): A loss of global cognitive ability of sufficient amount to interfere with normal social or occupational function. Dementia represents a loss of previously present cognitive abilities, generally in adults, and can affect memory, thinking, language, judgment, and behavior. Evidence: PCS. Frequency: 2/3. (PMID:19185523)
- X-linked recessive inheritance (HP:0001419): A mode of inheritance that is observed for recessive traits related to a gene encoded on the X chromosome. In the context of medical genetics, X-linked recessive disorders manifest in males (who have one copy of the X chromosome and are thus hemizygotes), but generally not in female heterozygotes who have one mutant and one normal allele. Evidence: PCS. (PMID:17262856)
- Myoclonus (HP:0001336): Very brief, involuntary random muscular contractions occurring at rest, in response to sensory stimuli, or accompanying voluntary movements. Evidence: PCS. Frequency: 1/3. (PMID:19185523)